- Aortic valve stenosis (HP:0001650): The presence of a stenosis (narrowing) of the aortic valve. Evidence: TAS. (OMIM:300960)
- Hypertonia (HP:0001276): A condition in which there is increased muscle tone so that arms or legs, for example, are stiff and difficult to move. Evidence: IEA. (OMIM:300960)
- Upslanted palpebral fissure (HP:0000582): The palpebral fissure inclination is more than two standard deviations above the mean for age (objective); or, the inclination of the palpebral fissure is greater than typical for age. Evidence: PCS. Frequency: 1/1. (PMID:12503101)
- Anterior polar cataract (HP:0001134): A polar cataract that affects the anterior pole of the lens. Evidence: PCS. Frequency: 1/1. (PMID:12503101)
- Short stature (HP:0004322): A height below that which is expected according to age and gender norms. Although there is no universally accepted definition of short stature, many refer to "short stature" as height more than 2 standard deviations below the mean for age and gender (or below the 3rd percentile for age and gender dependent norms). Evidence: TAS. (OMIM:300960)
- Seizure (HP:0001250): A seizure is an intermittent abnormality of nervous system physiology characterized by a transient occurrence of signs and/or symptoms due to abnormal excessive or synchronous neuronal activity in the brain. Evidence: TAS. Frequency: 1/1. (OMIM:300960)
- Hypotonia (HP:0001252): Hypotonia is an abnormally low muscle tone (the amount of tension or resistance to movement in a muscle). Even when relaxed, muscles have a continuous and passive partial contraction which provides some resistance to passive stretching. Hypotonia thus manifests as diminished resistance to passive stretching. Hypotonia is not the same as muscle weakness, although the two conditions can co-exist. Evidence: TAS. Frequency: 1/1. (OMIM:300960)
- Polydactyly (HP:0010442): A congenital anomaly characterized by the presence of supernumerary fingers or toes. Evidence: TAS. (OMIM:300960)
- Spotty hypopigmentation (HP:0005590). Evidence: PCS. Frequency: 1/1. (PMID:12503101)
- Cataract (HP:0000518): A cataract is an opacity or clouding that develops in the crystalline lens of the eye or in its capsule. Evidence: TAS. (OMIM:300960)
- Failure to thrive (HP:0001508): Failure to thrive (FTT) refers to a child whose physical growth is substantially below the norm. Evidence: PCS. Frequency: 1/1. (PMID:12503101)
- Broad hallux (HP:0010055): Visible increase in width of the hallux without an increase in the dorso-ventral dimension. Evidence: PCS. Frequency: 1/1. (PMID:12503101)
- Smooth philtrum (HP:0000319): Flat skin surface, with no ridge formation in the central region of the upper lip between the nasal base and upper vermilion border. Evidence: PCS. Frequency: 1/1. (PMID:12503101)
- Overlapping toe (HP:0001845): Describes a foot digit resting on the dorsal surface of an adjacent digit when the foot is at rest. Initially clawing may be dynamic and only noticeable on walking. Over time the plantar plate tears, subluxation occurs at the metatarsophalangeal joint (MTPJ), and the deformity becomes permanent. Evidence: TAS. Frequency: 1/1. (OMIM:300960)
- Bulbous nose (HP:0000414): Increased volume and globular shape of the anteroinferior aspect of the nose. Evidence: PCS. Frequency: 1/1. (PMID:12503101)
- Dandy-Walker malformation (HP:0001305): A congenital brain malformation typically characterized by incomplete formation of the cerebellar vermis, dilation of the fourth ventricle, and enlargement of the posterior fossa. In layman's terms, Dandy Walker malformation is a cyst in the cerebellum (typically symmetrical) that is involved with the fourth ventricle. This may interfere with the ability to drain cerebrospinal fluid from the brain, resulting in hydrocephalus. Dandy Walker cysts are formed during early embryonic development, while the brain forms. The cyst in the cerebellum typically has several blood vessels running through it connecting to the brain, thereby prohibiting surgical removal. Evidence: TAS. (OMIM:300960)
- Hydrocephalus (HP:0000238): Hydrocephalus is an active distension of the ventricular system of the brain resulting from inadequate passage of CSF from its point of production within the cerebral ventricles to its point of absorption into the systemic circulation. Evidence: TAS. (OMIM:300960)
- Long fingers (HP:0100807): The middle finger is more than 2 SD above the mean for newborns 27 to 41 weeks EGA or above the 97th centile for children from birth to 16 years of age AND the five digits retain their normal length proportions relative to each other (i.e., it is not the case that the middle finger is the only lengthened digit), or, Fingers that appear disproportionately long compared to the palm of the hand. Evidence: TAS. Frequency: 1/1. (OMIM:300960)
- Reduced visual acuity (HP:0007663). Evidence: PCS. Frequency: 1/1. (PMID:12503101)
- High palate (HP:0000218): Height of the palate more than 2 SD above the mean (objective) or palatal height at the level of the first permanent molar more than twice the height of the teeth (subjective). Evidence: TAS. Frequency: 1/1. (OMIM:300960)
- Crossed fused renal ectopia (HP:0004736): A developmental anomaly in which the kidneys are fused and localized on the same side of the midline. This anomaly is thought to result from disruption of the normal embryologic migration of the kidneys. Evidence: PCS. Frequency: 1/1. (PMID:12503101)
- Hyperactivity (HP:0000752): Hyperactivity is a condition characterized by constant and unusually high levels of activity, even in situations where it is deemed inappropriate. Evidence: TAS. (OMIM:300960)
- Macular hypoplasia (HP:0001104): Underdevelopment of the macula lutea. Evidence: PCS. Frequency: 1/1. (PMID:12503101)
- Redundant neck skin (HP:0005989): Excess skin around the neck, often lying in horizontal folds. Evidence: PCS. Frequency: 1/1. (PMID:12503101)
- Intellectual disability (HP:0001249): The term intellectual disability or intellectual developmental disorder is used to describe significantly sub-average intellectual and adaptive functioning based on clinical assessment and as measured by individually administered, appropriately normed, standardized and validated tests of intellectual functioning and adaptive behavior, with onset during the developmental period from infancy through adolescence. Evidence: TAS. (OMIM:300960)
- Posteriorly rotated ears (HP:0000358): A type of abnormal location of the ears in which the position of the ears is characterized by posterior rotation (the superior part of the ears is rotated towards the back of the head, and the inferior part of the ears towards the front). Evidence: PCS. Frequency: 1/1. (PMID:12503101)
- Small anterior fontanelle (HP:0000237): Abnormally decreased size of the anterior fontanelle with respect to age-dependent norms. Evidence: PCS. Frequency: 1/1. (PMID:12503101)
- Axial hypotonia (HP:0008936): Muscular hypotonia (abnormally low muscle tone) affecting the musculature of the trunk. Evidence: PCS. Frequency: 1/1. (PMID:12503101)
- Overfolded helix (HP:0000396): A condition in which the helix is folded over to a greater degree than normal. That is, excessive curling of the helix edge, whereby the free edge is parallel to the plane of the ear. Evidence: PCS. Frequency: 1/1. (PMID:12503101)
- Long neck (HP:0000472): Increased inferior-superior length of the neck. Evidence: PCS. Frequency: 1/1. (PMID:12503101)
- Absent speech (HP:0001344): Complete lack of development of speech and language abilities. Evidence: PCS. Frequency: 1/1. (PMID:12503101)
- Global developmental delay (HP:0001263): A delay in the achievement of motor or mental milestones in the domains of development of a child, including motor skills, speech and language, cognitive skills, and social and emotional skills. This term should only be used to describe children younger than five years of age. Evidence: TAS. Frequency: 1/1. (OMIM:300960)
- 2-3 toe syndactyly (HP:0004691): Syndactyly with fusion of toes two and three. Evidence: TAS. (OMIM:300960)
- Narrow palpebral fissure (HP:0045025): Reduction in the vertical distance between the upper and lower eyelids. Evidence: PCS. Frequency: 1/1. (PMID:12503101)
- Midface retrusion (HP:0011800): Posterior positions and/or vertical shortening of the infraorbital and perialar regions, or increased concavity of the face and/or reduced nasolabial angle. Evidence: TAS. (OMIM:300960)
- Overlapping fingers (HP:0010557): A finger resting on the dorsal surface of an adjacent digit when the hand is at rest. Evidence: TAS. Frequency: 1/1. (OMIM:300960)
- Ichthyosis (HP:0008064): An abnormality of the skin characterized the presence of excessive amounts of dry surface scales on the skin resulting from an abnormality of keratinization. Evidence: TAS. (OMIM:300960)
- Kyphosis (HP:0002808): Exaggerated anterior convexity of the thoracic vertebral column. Evidence: IEA. (OMIM:300960)
- Microretrognathia (HP:0000308): A form of developmental hypoplasia of the mandible in which the mandible is mislocalised posteriorly. Evidence: TAS. (OMIM:300960)
- X-linked recessive inheritance (HP:0001419): A mode of inheritance that is observed for recessive traits related to a gene encoded on the X chromosome. In the context of medical genetics, X-linked recessive disorders manifest in males (who have one copy of the X chromosome and are thus hemizygotes), but generally not in female heterozygotes who have one mutant and one normal allele. Evidence: PCS. (PMID:12503101)
- Prominent nasal bridge (HP:0000426): Anterior positioning of the nasal root in comparison to the usual positioning for age. Evidence: TAS. Frequency: 1/1. (OMIM:300960)
- Esotropia (HP:0000565): A form of strabismus with one or both eyes turned inward ('crossed') to a relatively severe degree, usually defined as 10 diopters or more. Evidence: PCS. Frequency: 1/1. (PMID:12503101)
- Sacral dimple (HP:0000960): A cutaneous indentation resulting from tethering of the skin to underlying structures (bone) of the intergluteal cleft. Evidence: PCS. Frequency: 1/1. (PMID:12503101)
- Cryptorchidism (HP:0000028): Testis in inguinal canal. That is, absence of one or both testes from the scrotum owing to failure of the testis or testes to descend through the inguinal canal to the scrotum. Evidence: TAS. (OMIM:300960)
- Low-set ears (HP:0000369): Upper insertion of the ear to the scalp below an imaginary horizontal line drawn between the inner canthi of the eye and extending posteriorly to the ear. Evidence: TAS. Frequency: 1/1. (OMIM:300960)
- Micrognathia (HP:0000347): Developmental hypoplasia of the mandible. Evidence: PCS. Frequency: 1/1. (PMID:12503101)
These phenotypes are associated with the disease MEND syndrome (OMIM:300960).